Phenotypes associated with the disease PEHO syndrome (ORPHA:2836):
- Abnormal pinna morphology (HP:0000377): An abnormality of the pinna, which is also referred to as the auricle or external ear. Evidence: TAS. Frequency: Very frequent (HP:0040281). (ORPHA:2836)
- Abnormal palate morphology (HP:0000174): Any abnormality of the palate, i.e., of roof of the mouth. Evidence: TAS. Frequency: Very frequent (HP:0040281). (ORPHA:2836)
- Abnormal upper lip morphology (HP:0000177): An abnormality of the upper lip. Evidence: TAS. Frequency: Very frequent (HP:0040281). (ORPHA:2836)
- Open mouth (HP:0000194): A facial appearance characterized by a permanently or nearly permanently opened mouth. Evidence: TAS. Frequency: Very frequent (HP:0040281). (ORPHA:2836)
- Malar flattening (HP:0000272): Underdevelopment of the malar prominence of the jugal bone (zygomatic bone in mammals), appreciated in profile, frontal view, and/or by palpation. Evidence: TAS. Frequency: Very frequent (HP:0040281). (ORPHA:2836)
- Epicanthus (HP:0000286): A fold of skin starting above the medial aspect of the upper eyelid and arching downward to cover, pass in front of and lateral to the medial canthus. Evidence: TAS. Frequency: Very frequent (HP:0040281). (ORPHA:2836)
- Full cheeks (HP:0000293): Increased prominence or roundness of soft tissues between zygomata and mandible. Evidence: TAS. Frequency: Very frequent (HP:0040281). (ORPHA:2836)
- Macrotia (HP:0000400): Median longitudinal ear length greater than two standard deviations above the mean and median ear width greater than two standard deviations above the mean (objective); or, apparent increase in length and width of the pinna (subjective). Evidence: TAS. Frequency: Very frequent (HP:0040281). (ORPHA:2836)
- Abnormality of eye movement (HP:0000496): An abnormality in voluntary or involuntary eye movements or their control. Evidence: TAS. Frequency: Very frequent (HP:0040281). (ORPHA:2836)
- Visual loss (HP:0000572): Loss of visual acuity (implying that vision was better at a certain time point in life). Otherwise the term reduced visual acuity should be used (or a subclass of that). Evidence: TAS. Frequency: Very frequent (HP:0040281). (ORPHA:2836)
- Optic atrophy (HP:0000648): Atrophy of the optic nerve. Optic atrophy results from the death of the retinal ganglion cell axons that comprise the optic nerve and manifesting as a pale optic nerve on fundoscopy. Evidence: TAS. Frequency: Very frequent (HP:0040281). (ORPHA:2836)
- Tapered finger (HP:0001182): The gradual reduction in girth of the finger from proximal to distal. Evidence: TAS. Frequency: Very frequent (HP:0040281). (ORPHA:2836)
- Seizure (HP:0001250): A seizure is an intermittent abnormality of nervous system physiology characterized by a transient occurrence of signs and/or symptoms due to abnormal excessive or synchronous neuronal activity in the brain. Evidence: TAS. Frequency: Very frequent (HP:0040281). (ORPHA:2836)
- Global developmental delay (HP:0001263): A delay in the achievement of motor or mental milestones in the domains of development of a child, including motor skills, speech and language, cognitive skills, and social and emotional skills. This term should only be used to describe children younger than five years of age. Evidence: TAS. Frequency: Very frequent (HP:0040281). (ORPHA:2836)
- Hyperreflexia (HP:0001347): Hyperreflexia is the presence of hyperactive stretch reflexes of the muscles. Evidence: TAS. Frequency: Very frequent (HP:0040281). (ORPHA:2836)
- Cerebral cortical atrophy (HP:0002120): Atrophy of the cortex of the cerebrum. Evidence: TAS. Frequency: Very frequent (HP:0040281). (ORPHA:2836)
- Drowsiness (HP:0002329): Abnormal feeling of sleepiness or difficulty staying awake. Evidence: TAS. Frequency: Very frequent (HP:0040281). (ORPHA:2836)
- EEG abnormality (HP:0002353): Abnormality observed by electroencephalogram (EEG), which is used to record of the brain's spontaneous electrical activity from multiple electrodes placed on the scalp. Evidence: TAS. Frequency: Very frequent (HP:0040281). (ORPHA:2836)
- Hypsarrhythmia (HP:0002521): Hypsarrhythmia is abnormal interictal high amplitude waves and a background of irregular spikes. There is continuous (during wakefulness), high-amplitude (>200 Hz), generalized polymorphic slowing with no organized background and multifocal spikes demonstrated by electroencephalography (EEG). Evidence: TAS. Frequency: Very frequent (HP:0040281). (ORPHA:2836)
- Short nose (HP:0003196): Distance from nasion to subnasale more than two standard deviations below the mean, or alternatively, an apparently decreased length from the nasal root to the nasal tip. Evidence: TAS. Frequency: Very frequent (HP:0040281). (ORPHA:2836)
- Biparietal narrowing (HP:0004422): A narrowing of the biparietal diameter (i.e., of the transverse distance between the protuberances of the two parietal bones of the skull). Evidence: TAS. Frequency: Very frequent (HP:0040281). (ORPHA:2836)
- Severe muscular hypotonia (HP:0006829): A severe degree of muscular hypotonia characterized by markedly reduced muscle tone. Evidence: TAS. Frequency: Very frequent (HP:0040281). (ORPHA:2836)
- Severe intellectual disability (HP:0010864): Severe intellectual disability (ID) is defined as a type of ID characterized by severely sub-average adaptive functioning and intellectual functioning, with an intelligence quotient (IQ) the range of 20-34. Evidence: TAS. Frequency: Very frequent (HP:0040281). (ORPHA:2836)
- Midface retrusion (HP:0011800): Posterior positions and/or vertical shortening of the infraorbital and perialar regions, or increased concavity of the face and/or reduced nasolabial angle. Evidence: TAS. Frequency: Very frequent (HP:0040281). (ORPHA:2836)
- Feeding difficulties (HP:0011968): Impaired ability to eat related to problems gathering food and getting ready to suck, chew, or swallow it. Evidence: TAS. Frequency: Very frequent (HP:0040281). (ORPHA:2836)
- Infantile spasms (HP:0012469): Infantile spasms represent a subset of "epileptic spasms". Infantile Spasms are epileptic spasms starting in the first year of life (infancy). Evidence: TAS. Frequency: Very frequent (HP:0040281). (ORPHA:2836)
- Abnormality of movement (HP:0100022): An abnormality of movement with a neurological basis characterized by changes in coordination and speed of voluntary movements. Evidence: TAS. Frequency: Very frequent (HP:0040281). (ORPHA:2836)
- Gingival overgrowth (HP:0000212): Hyperplasia of the gingiva (that is, a thickening of the soft tissue overlying the alveolar ridge. The degree of thickening ranges from involvement of the interdental papillae alone to gingival overgrowth covering the entire tooth crown. Evidence: TAS. Frequency: Frequent (HP:0040282). (ORPHA:2836)
- Hydrocephalus (HP:0000238): Hydrocephalus is an active distension of the ventricular system of the brain resulting from inadequate passage of CSF from its point of production within the cerebral ventricles to its point of absorption into the systemic circulation. Evidence: TAS. Frequency: Frequent (HP:0040282). (ORPHA:2836)
- Microcephaly (HP:0000252): Head circumference below 2 standard deviations below the mean for age and gender. Evidence: TAS. Frequency: Frequent (HP:0040282). (ORPHA:2836)
- Anteverted nares (HP:0000463): Anteriorly-facing nostrils viewed with the head in the Frankfurt horizontal and the eyes of the observer level with the eyes of the subject. This gives the appearance of an upturned nose (upturned nasal tip). Evidence: TAS. Frequency: Frequent (HP:0040282). (ORPHA:2836)
- Cerebellar atrophy (HP:0001272): Cerebellar atrophy is defined as a cerebellum with initially normal structures, in a posterior fossa with normal size, which displays enlarged fissures (interfolial spaces) in comparison to the foliae secondary to loss of tissue. Cerebellar atrophy implies irreversible loss of tissue and result from an ongoing progressive disease until a final stage is reached or a single injury, e.g. an intoxication or infectious event. Evidence: TAS. Frequency: Frequent (HP:0040282). (ORPHA:2836)
- Flexion contracture (HP:0001371): A flexion contracture is a bent (flexed) joint that cannot be straightened actively or passively. It is thus a chronic loss of joint motion due to structural changes in muscle, tendons, ligaments, or skin that prevents normal movement of joints. Evidence: TAS. Frequency: Frequent (HP:0040282). (ORPHA:2836)
- Limitation of joint mobility (HP:0001376): A reduction in the freedom of movement of one or more joints. Evidence: TAS. Frequency: Frequent (HP:0040282). (ORPHA:2836)
- Ventriculomegaly (HP:0002119): An increase in size of the ventricular system of the brain. Evidence: TAS. Frequency: Frequent (HP:0040282). (ORPHA:2836)
- Porencephalic cyst (HP:0002132): A cavity within the cerebral hemisphere, filled with cerebrospinal fluid, that communicates directly with the ventricular system. Evidence: TAS. Frequency: Frequent (HP:0040282). (ORPHA:2836)
- Recurrent respiratory infections (HP:0002205): An increased susceptibility to respiratory infections as manifested by a history of recurrent respiratory infections. Evidence: TAS. Frequency: Frequent (HP:0040282). (ORPHA:2836)
- Atrophy/Degeneration affecting the brainstem (HP:0007366). Evidence: TAS. Frequency: Frequent (HP:0040282). (ORPHA:2836)
- Pedal edema (HP:0010741): An abnormal accumulation of excess fluid in the lower extremity resulting in swelling of the feet and extending upward to the lower leg. Evidence: TAS. Frequency: Frequent (HP:0040282). (ORPHA:2836)
- Peripheral edema (HP:0012398): An abnormal accumulation of interstitial fluid in the soft tissues of the limbs. Evidence: TAS. Frequency: Frequent (HP:0040282). (ORPHA:2836)
- Palpebral edema (HP:0100540): Edema in the region of the eyelids. Evidence: TAS. Frequency: Frequent (HP:0040282). (ORPHA:2836)
- Arthrogryposis multiplex congenita (HP:0002804): Multiple congenital contractures in different body areas. Evidence: TAS. Frequency: Occasional (HP:0040283). (ORPHA:2836)